- Encephalopathy (HP:0001298): Encephalopathy is a term that means brain disease, damage, or malfunction. In general, encephalopathy is manifested by an altered mental state. Evidence: PCS. Frequency: 1/1. (PMID:27334371)
- Epicanthus (HP:0000286): A fold of skin starting above the medial aspect of the upper eyelid and arching downward to cover, pass in front of and lateral to the medial canthus. Evidence: IEA. (OMIM:617268)
- Strabismus (HP:0000486): A misalignment of the eyes so that the visual axes deviate from bifoveal fixation. The classification of strabismus may be based on a number of features including the relative position of the eyes, whether the deviation is latent or manifest, intermittent or constant, concomitant or otherwise and according to the age of onset and the relevance of any associated refractive error. Evidence: PCS. Frequency: 3/7. (PMID:27389779)
- Anteverted nares (HP:0000463): Anteriorly-facing nostrils viewed with the head in the Frankfurt horizontal and the eyes of the observer level with the eyes of the subject. This gives the appearance of an upturned nose (upturned nasal tip). Evidence: PCS. (PMID:27389779)
- Dystonia (HP:0001332): An abnormally increased muscular tone that causes fixed abnormal postures. There is a slow, intermittent twisting motion that leads to exaggerated turning and posture of the extremities and trunk. Evidence: PCS. Frequency: 1/1. (PMID:27334371)
- Seizure (HP:0001250): A seizure is an intermittent abnormality of nervous system physiology characterized by a transient occurrence of signs and/or symptoms due to abnormal excessive or synchronous neuronal activity in the brain. Evidence: PCS. Frequency: 6/7. Onset: Infantile onset (HP:0003593). (PMID:27389779)
- Hypotonia (HP:0001252): Hypotonia is an abnormally low muscle tone (the amount of tension or resistance to movement in a muscle). Even when relaxed, muscles have a continuous and passive partial contraction which provides some resistance to passive stretching. Hypotonia thus manifests as diminished resistance to passive stretching. Hypotonia is not the same as muscle weakness, although the two conditions can co-exist. Evidence: PCS. Frequency: 1/1. (PMID:27334371)
- Generalized hypotonia (HP:0001290): Generalized muscular hypotonia (abnormally low muscle tone). Evidence: PCS. Frequency: 7/7. (PMID:27389779)
- Sparse eyebrow (HP:0045075): Decreased density/number of eyebrow hairs. Evidence: IEA. (OMIM:617268)
- Nystagmus (HP:0000639): Rhythmic, involuntary oscillations of one or both eyes related to abnormality in fixation, conjugate gaze, or vestibular mechanisms. Evidence: IEA. (OMIM:617268)
- Cerebral visual impairment (HP:0100704): A form of loss of vision caused by damage to the visual cortex rather than a defect in the eye. Evidence: PCS. Frequency: 3/7. (PMID:27389779)
- Osteopenia (HP:0000938): Osteopenia is a term to define bone density that is not normal but also not as low as osteoporosis. By definition from the World Health Organization osteopenia is defined by bone densitometry as a T score -1 to -2.5. Evidence: PCS. Frequency: 3/7. (PMID:27389779)
- Prominent forehead (HP:0011220): Forward prominence of the entire forehead, due to protrusion of the frontal bone. Evidence: PCS. (PMID:27389779)
- Bulbous nose (HP:0000414): Increased volume and globular shape of the anteroinferior aspect of the nose. Evidence: PCS. (PMID:27389779)
- Ventriculomegaly (HP:0002119): An increase in size of the ventricular system of the brain. Evidence: PCS. Frequency: 1/1. (PMID:27334371)
- Macrocephaly (HP:0000256): Occipitofrontal (head) circumference greater than 97th centile compared to appropriate, age matched, sex-matched normal standards. Alternatively, a apparently increased size of the cranium. Evidence: PCS. Frequency: 1/1. (PMID:27334371)
- Thick lower lip vermilion (HP:0000179): Increased thickness of the lower lip, leading to a prominent appearance of the lower lip. The height of the vermilion of the lower lip in the midline is more than 2 SD above the mean. Alternatively, an apparently increased height of the vermilion of the lower lip in the frontal view (subjective). Evidence: IEA. (OMIM:617268)
- Intellectual disability (HP:0001249): The term intellectual disability or intellectual developmental disorder is used to describe significantly sub-average intellectual and adaptive functioning based on clinical assessment and as measured by individually administered, appropriately normed, standardized and validated tests of intellectual functioning and adaptive behavior, with onset during the developmental period from infancy through adolescence. Evidence: PCS. Frequency: 4/4. (PMID:27389779)
- Wide mouth (HP:0000154): Distance between the oral commissures more than 2 SD above the mean. Alternatively, an apparently increased width of the oral aperture (subjective). Evidence: PCS. (PMID:27389779)
- Cerebral atrophy (HP:0002059): Atrophy (wasting, decrease in size of cells or tissue) affecting the cerebrum. Evidence: PCS. Frequency: 1/1. (PMID:27334371)
- Absent speech (HP:0001344): Complete lack of development of speech and language abilities. Evidence: PCS. Frequency: 1/1. (PMID:27334371)
- EEG abnormality (HP:0002353): Abnormality observed by electroencephalogram (EEG), which is used to record of the brain's spontaneous electrical activity from multiple electrodes placed on the scalp. Evidence: IEA. (OMIM:617268)
- Thick eyebrow (HP:0000574): Increased density/number and/or increased diameter of eyebrow hairs. Evidence: IEA. (OMIM:617268)
- Delayed ability to walk (HP:0031936): A failure to achieve the ability to walk at an appropriate developmental stage. Most children learn to walk in a series of stages, and learn to walk short distances independently between 12 and 15 months. Evidence: IEA. (OMIM:617268)
- Generalized-onset seizure (HP:0002197): A generalized-onset seizure is a type of seizure originating at some point within, and rapidly engaging, bilaterally distributed networks. The networks may include cortical and subcortical structures but not necessarily the entire cortex. Evidence: PCS. Frequency: 1/1. (PMID:27334371)
- Deeply set eye (HP:0000490): An eye that is more deeply recessed into the plane of the face than is typical. Evidence: PCS. Frequency: 3/7. (PMID:27389779)
- Global developmental delay (HP:0001263): A delay in the achievement of motor or mental milestones in the domains of development of a child, including motor skills, speech and language, cognitive skills, and social and emotional skills. This term should only be used to describe children younger than five years of age. Evidence: PCS. Frequency: 7/7. (PMID:27389779)
- Midface retrusion (HP:0011800): Posterior positions and/or vertical shortening of the infraorbital and perialar regions, or increased concavity of the face and/or reduced nasolabial angle. Evidence: PCS. (PMID:27389779)
- Depressed nasal bridge (HP:0005280): Posterior positioning of the nasal root in relation to the overall facial profile for age. Evidence: PCS. (PMID:27389779)
- Dyskinesia (HP:0100660): A movement disorder which consists of effects including diminished voluntary movements and the presence of involuntary movements. Evidence: PCS. Frequency: 1/1. (PMID:27334371)
- Recurrent hand flapping (HP:0100023): A type of repetitive behavior in which the affected individual repeatedly waves the hands and/or arms rhythmically. Evidence: PCS. Frequency: 4/7. (PMID:27389779)
- Telecanthus (HP:0000506): Distance between the inner canthi more than two standard deviations above the mean (objective); or, apparently increased distance between the inner canthi. Evidence: IEA. (OMIM:617268)
- Autistic behavior (HP:0000729): Persistent deficits in social interaction and communication and interaction as well as a markedly restricted repertoire of activity and interest as well as repetitive patterns of behavior. Evidence: PCS. Frequency: 2/3. (PMID:27389779)
- Nasogastric tube feeding (HP:0040288): The condition of inability to eat normally treated by placement of a thin tube through the nose into the stomach that is then used to carry food. Evidence: PCS. Frequency: 4/7. (PMID:27389779)
- Ptosis (HP:0000508): The upper eyelid margin is positioned 3 mm or more lower than usual and covers the superior portion of the iris (objective); or, the upper lid margin obscures at least part of the pupil (subjective). Evidence: PCS. Frequency: 2/7. (PMID:27389779)
- High, narrow palate (HP:0002705): The presence of a high and narrow palate. Evidence: PCS. (PMID:27389779)
- Self-injurious behavior (HP:0100716): Self-aggression. Evidence: PCS. Frequency: 2/7. (PMID:27389779)
- Macrotia (HP:0000400): Median longitudinal ear length greater than two standard deviations above the mean and median ear width greater than two standard deviations above the mean (objective); or, apparent increase in length and width of the pinna (subjective). Evidence: TAS. (OMIM:617268)
- Abnormal cerebral white matter morphology (HP:0002500): An abnormality of the cerebral white matter. Evidence: PCS. Frequency: 1/1. (PMID:27334371)
- Autosomal dominant inheritance (HP:0000006): A mode of inheritance that is observed for traits related to a gene encoded on one of the autosomes (i.e., the human chromosomes 1-22) in which a trait manifests in heterozygotes. In the context of medical genetics, an autosomal dominant disorder is caused when a single copy of the mutant allele is present. Males and females are affected equally, and can both transmit the disorder with a risk of 50% for each child of inheriting the mutant allele. Evidence: PCS. (PMID:27389779)
These phenotypes are associated with the disease neurodevelopmental disorder with hypotonia, seizures, and absent language (OMIM:617268).